- Photophobia (HP:0000613): Excessive sensitivity to light with the sensation of discomfort or pain in the eyes due to exposure to bright light. Evidence: TAS. Frequency: Very frequent (HP:0040281). (ORPHA:370097)
- Nystagmus (HP:0000639): Rhythmic, involuntary oscillations of one or both eyes related to abnormality in fixation, conjugate gaze, or vestibular mechanisms. Evidence: TAS. Frequency: Very frequent (HP:0040281). (ORPHA:370097)
- Abnormal fundus morphology (HP:0001098): Any structural abnormality of the fundus of the eye. Evidence: TAS. Frequency: Very frequent (HP:0040281). (ORPHA:370097)
- Reduced visual acuity (HP:0007663). Evidence: TAS. Frequency: Very frequent (HP:0040281). (ORPHA:370097)
- Abnormal iris pigmentation (HP:0008034): Abnormal pigmentation of the iris. Evidence: TAS. Frequency: Very frequent (HP:0040281). (ORPHA:370097)
- Aplasia/Hypoplasia of the macula (HP:0008059). Evidence: TAS. Frequency: Very frequent (HP:0040281). (ORPHA:370097)
- Abnormal foveal morphology on macular OCT (HP:0030613). Evidence: TAS. Frequency: Very frequent (HP:0040281). (ORPHA:370097)
These phenotypes are associated with the disease Oculocutaneous albinism type 6 (ORPHA:370097).